Phenotypes associated with the disease familial reactive perforating collagenosis (OMIM:216700):
- Abnormality of metabolism/homeostasis (HP:0001939). Evidence: IEA. (OMIM:216700)
- Autosomal recessive inheritance (HP:0000007): A mode of inheritance that is observed for traits related to a gene encoded on one of the autosomes (i.e., the human chromosomes 1-22) in which a trait manifests in individuals with two pathogenic alleles, either homozygotes (two copies of the same mutant allele) or compound heterozygotes (whereby each copy of a gene has a distinct mutant allele). Evidence: IEA. (OMIM:216700)
- Abnormality of the skin (HP:0000951): An abnormality of the skin. Evidence: IEA. (OMIM:216700)